Phenotypes associated with the disease Alopecia-contractures-dwarfism-intellectual disability syndrome (ORPHA:1005):
- Posteriorly rotated ears (HP:0000358): A type of abnormal location of the ears in which the position of the ears is characterized by posterior rotation (the superior part of the ears is rotated towards the back of the head, and the inferior part of the ears towards the front). Evidence: TAS. Frequency: Frequent (HP:0040282). (ORPHA:1005)
- Hypohidrosis (HP:0000966): Abnormally diminished capacity to sweat. Evidence: TAS. Frequency: Very frequent (HP:0040281). (ORPHA:1005)
- Intellectual disability (HP:0001249): The term intellectual disability or intellectual developmental disorder is used to describe significantly sub-average intellectual and adaptive functioning based on clinical assessment and as measured by individually administered, appropriately normed, standardized and validated tests of intellectual functioning and adaptive behavior, with onset during the developmental period from infancy through adolescence. Evidence: TAS. Frequency: Very frequent (HP:0040281). (ORPHA:1005)
- Joint stiffness (HP:0001387): Joint stiffness is a perceived sensation of tightness in a joint or joints when attempting to move them after a period of inactivity. Joint stiffness typically subsides over time. Evidence: TAS. Frequency: Very frequent (HP:0040281). (ORPHA:1005)
- Alopecia (HP:0001596): A noncongenital process of hair loss, which may progress to partial or complete baldness. Evidence: TAS. Frequency: Very frequent (HP:0040281). (ORPHA:1005)
- Kyphosis (HP:0002808): Exaggerated anterior convexity of the thoracic vertebral column. Evidence: TAS. Frequency: Very frequent (HP:0040281). (ORPHA:1005)
- Severe short stature (HP:0003510): A severe degree of short stature, more than -4 SD from the mean corrected for age and sex. Evidence: TAS. Frequency: Very frequent (HP:0040281). (ORPHA:1005)
- Intellectual disability (HP:0001249): The term intellectual disability or intellectual developmental disorder is used to describe significantly sub-average intellectual and adaptive functioning based on clinical assessment and as measured by individually administered, appropriately normed, standardized and validated tests of intellectual functioning and adaptive behavior, with onset during the developmental period from infancy through adolescence. Evidence: TAS. Frequency: Very frequent (HP:0040281). (ORPHA:1005)
- Sparse hair (HP:0008070): Reduced density of hairs. Evidence: TAS. Frequency: Very frequent (HP:0040281). (ORPHA:1005)
- Microcephaly (HP:0000252): Head circumference below 2 standard deviations below the mean for age and gender. Evidence: TAS. Frequency: Frequent (HP:0040282). (ORPHA:1005)
- Turricephaly (HP:0000262): Tall head relative to width and length. Evidence: TAS. Frequency: Frequent (HP:0040282). (ORPHA:1005)
- Hypertelorism (HP:0000316): Interpupillary distance more than 2 SD above the mean (alternatively, the appearance of an increased interpupillary distance or widely spaced eyes). Evidence: TAS. Frequency: Frequent (HP:0040282). (ORPHA:1005)
- Macrotia (HP:0000400): Median longitudinal ear length greater than two standard deviations above the mean and median ear width greater than two standard deviations above the mean (objective); or, apparent increase in length and width of the pinna (subjective). Evidence: TAS. Frequency: Frequent (HP:0040282). (ORPHA:1005)
- Prominent nose (HP:0000448): Distance between subnasale and pronasale more than two standard deviations above the mean, or alternatively, an apparently increased anterior protrusion of the nasal tip. Evidence: TAS. Frequency: Frequent (HP:0040282). (ORPHA:1005)
- Myopia (HP:0000545): An abnormality of refraction characterized by the ability to see objects nearby clearly, while objects in the distance appear blurry. Evidence: TAS. Frequency: Frequent (HP:0040282). (ORPHA:1005)
- Upslanted palpebral fissure (HP:0000582): The palpebral fissure inclination is more than two standard deviations above the mean for age (objective); or, the inclination of the palpebral fissure is greater than typical for age. Evidence: TAS. Frequency: Frequent (HP:0040282). (ORPHA:1005)
- Abnormal dental enamel morphology (HP:0000682): An abnormality of the dental enamel. Evidence: TAS. Frequency: Frequent (HP:0040282). (ORPHA:1005)
- Hyperkeratosis (HP:0000962): Hyperkeratosis is a histopathological term defining a thickened stratum corneum and may be present in many different skin conditions, with many possible overlaps. Hyperkeratosis refers to the increased thickness of the stratum corneum, the outer layer of the skin. Hyperkeratosis is subclassified as orthokeratotic or parakeratotic. Orthokeratotic hyperkeratosis refers to the thickening of the keratin layer with preserved keratinocyte maturation, while parakeratotic hyperkeratosis shows retained nuclei as a sign of delayed maturation of keratinocytes. Evidence: TAS. Frequency: Frequent (HP:0040282). (ORPHA:1005)
- Brachydactyly (HP:0001156): Digits that appear disproportionately short compared to the hand/foot. The word brachydactyly is used here to describe a series distinct patterns of shortened digits (brachydactyly types A-E). This is the sense used here. Evidence: TAS. Frequency: Frequent (HP:0040282). (ORPHA:1005)
- Intrauterine growth retardation (HP:0001511): An abnormal restriction of fetal growth with fetal weight below the tenth percentile for gestational age. Evidence: TAS. Frequency: Frequent (HP:0040282). (ORPHA:1005)
- Vertebral segmentation defect (HP:0003422): An abnormality related to a defect of vertebral separation during development. Evidence: TAS. Frequency: Frequent (HP:0040282). (ORPHA:1005)
- Clinodactyly of the 5th finger (HP:0004209): Clinodactyly refers to a bending or curvature of the fifth finger in the radial direction (i.e., towards the 4th finger). Evidence: TAS. Frequency: Frequent (HP:0040282). (ORPHA:1005)
- Biparietal narrowing (HP:0004422): A narrowing of the biparietal diameter (i.e., of the transverse distance between the protuberances of the two parietal bones of the skull). Evidence: TAS. Frequency: Frequent (HP:0040282). (ORPHA:1005)
- Synostosis of carpal bones (HP:0005048). Evidence: TAS. Frequency: Frequent (HP:0040282). (ORPHA:1005)
- Short middle phalanx of finger (HP:0005819): Short (hypoplastic) middle phalanx of finger, affecting one or more fingers. Evidence: TAS. Frequency: Frequent (HP:0040282). (ORPHA:1005)
- Finger syndactyly (HP:0006101): Webbing or fusion of the fingers, involving soft parts only or including bone structure. Bony fusions are referred to as "bony" Syndactyly if the fusion occurs in a radio-ulnar axis. Fusions of bones of the fingers in a proximo-distal axis are referred to as "Symphalangism". Evidence: TAS. Frequency: Frequent (HP:0040282). (ORPHA:1005)
- Abnormal toenail morphology (HP:0008388): An anomaly of the toenail. Evidence: TAS. Frequency: Frequent (HP:0040282). (ORPHA:1005)
- Moderate postnatal growth retardation (HP:0008855): A moderate degree of slow or limited growth after birth, being between three and four standard deviations below age- and sex-related norms. Evidence: TAS. Frequency: Frequent (HP:0040282). (ORPHA:1005)
- Abnormal antihelix morphology (HP:0009738): An abnormality of the antihelix. Evidence: TAS. Frequency: Frequent (HP:0040282). (ORPHA:1005)
- Abnormality of the elbow (HP:0009811): An anomaly of the joint that connects the upper and the lower arm. Evidence: TAS. Frequency: Frequent (HP:0040282). (ORPHA:1005)
- Abnormal helix morphology (HP:0011039): An abnormality of the helix. The helix is the outer rim of the ear that extends from the insertion of the ear on the scalp (root) to the termination of the cartilage at the earlobe. Evidence: TAS. Frequency: Frequent (HP:0040282). (ORPHA:1005)
- Abnormality of the skeletal system (HP:0000924): An abnormality of the skeletal system. Evidence: TAS. Frequency: Occasional (HP:0040283). (ORPHA:1005)
- Scoliosis (HP:0002650): The presence of an abnormal lateral curvature of the spine. Evidence: TAS. Frequency: Occasional (HP:0040283). (ORPHA:1005)
- Hip dislocation (HP:0002827): Displacement of the femur from its normal location in the hip joint. Evidence: TAS. Frequency: Occasional (HP:0040283). (ORPHA:1005)
- Ichthyosis (HP:0008064): An abnormality of the skin characterized the presence of excessive amounts of dry surface scales on the skin resulting from an abnormality of keratinization. Evidence: TAS. Frequency: Occasional (HP:0040283). (ORPHA:1005)